Phenotypes associated with the disease hyperparathyroidism, primary, caused by water clear cell hyperplasia (OMIM:600166):
- Primary hyperparathyroidism (HP:0008200): A type of hyperparathyroidism caused by a primary abnormality of the parathyroid glands (e.g., adenoma, carcinoma, hyperplasia). Primary hyperparathyroidism is associated with hyercalcemia. Evidence: IEA. (OMIM:600166)
- Autosomal dominant inheritance (HP:0000006): A mode of inheritance that is observed for traits related to a gene encoded on one of the autosomes (i.e., the human chromosomes 1-22) in which a trait manifests in heterozygotes. In the context of medical genetics, an autosomal dominant disorder is caused when a single copy of the mutant allele is present. Males and females are affected equally, and can both transmit the disorder with a risk of 50% for each child of inheriting the mutant allele. Evidence: IEA. (OMIM:600166)